Phenotypes associated with the disease Phenobarbital embryopathy (ORPHA:1919):
- Epicanthus (HP:0000286): A fold of skin starting above the medial aspect of the upper eyelid and arching downward to cover, pass in front of and lateral to the medial canthus. Evidence: TAS. Frequency: Frequent (HP:0040282). (ORPHA:1919)
- Mandibular prognathia (HP:0000303): Abnormal prominence of the chin related to increased length of the mandible. Evidence: TAS. Frequency: Frequent (HP:0040282). (ORPHA:1919)
- Hypertelorism (HP:0000316): Interpupillary distance more than 2 SD above the mean (alternatively, the appearance of an increased interpupillary distance or widely spaced eyes). Evidence: TAS. Frequency: Frequent (HP:0040282). (ORPHA:1919)
- Low-set ears (HP:0000369): Upper insertion of the ear to the scalp below an imaginary horizontal line drawn between the inner canthi of the eye and extending posteriorly to the ear. Evidence: TAS. Frequency: Frequent (HP:0040282). (ORPHA:1919)
- Brachydactyly (HP:0001156): Digits that appear disproportionately short compared to the hand/foot. The word brachydactyly is used here to describe a series distinct patterns of shortened digits (brachydactyly types A-E). This is the sense used here. Evidence: TAS. Frequency: Frequent (HP:0040282). (ORPHA:1919)
- Intellectual disability (HP:0001249): The term intellectual disability or intellectual developmental disorder is used to describe significantly sub-average intellectual and adaptive functioning based on clinical assessment and as measured by individually administered, appropriately normed, standardized and validated tests of intellectual functioning and adaptive behavior, with onset during the developmental period from infancy through adolescence. Evidence: TAS. Frequency: Frequent (HP:0040282). (ORPHA:1919)
- Global developmental delay (HP:0001263): A delay in the achievement of motor or mental milestones in the domains of development of a child, including motor skills, speech and language, cognitive skills, and social and emotional skills. This term should only be used to describe children younger than five years of age. Evidence: TAS. Frequency: Frequent (HP:0040282). (ORPHA:1919)
- Aplasia/Hypoplasia of the nails (HP:0008386): Aplasia or developmental hypoplasia of the nail. Evidence: TAS. Frequency: Frequent (HP:0040282). (ORPHA:1919)
- Abnormal nasal base norphology (HP:0012808): An anomaly of the nasal base, which can be conceived of as an imaginary line between the most lateral points of the external inferior attachments of the alae nasi to the face. Evidence: TAS. Frequency: Frequent (HP:0040282). (ORPHA:1919)
- Unilateral cleft lip (HP:0100333): A non-midline cleft of the upper lip on one side only. Evidence: TAS. Frequency: Frequent (HP:0040282). (ORPHA:1919)
- Hypospadias (HP:0000047): Abnormal position of urethral meatus on the ventral penile shaft (underside) characterized by displacement of the urethral meatus from the tip of the glans penis to the ventral surface of the penis, scrotum, or perineum. Evidence: TAS. Frequency: Occasional (HP:0040283). (ORPHA:1919)
- Microcephaly (HP:0000252): Head circumference below 2 standard deviations below the mean for age and gender. Evidence: TAS. Frequency: Occasional (HP:0040283). (ORPHA:1919)
- Malar flattening (HP:0000272): Underdevelopment of the malar prominence of the jugal bone (zygomatic bone in mammals), appreciated in profile, frontal view, and/or by palpation. Evidence: TAS. Frequency: Occasional (HP:0040283). (ORPHA:1919)
- Abnormal mitral valve morphology (HP:0001633): Any structural anomaly of the mitral valve. Evidence: TAS. Frequency: Occasional (HP:0040283). (ORPHA:1919)
- Tetralogy of Fallot (HP:0001636): A congenital cardiac malformation comprising pulmonary stenosis, overriding aorta, ventricular septum defect, and right ventricular hypertrophy. The diagnosis of TOF is made if at least three of the four above mentioned features are present. Evidence: TAS. Frequency: Occasional (HP:0040283). (ORPHA:1919)
- Aplasia/Hypoplasia of fingers (HP:0006265): Small/hypoplastic or absent/aplastic fingers. Evidence: TAS. Frequency: Occasional (HP:0040283). (ORPHA:1919)